Phenotypes associated with the disease familial idiopathic inflammatory myopathy (OMIM:160750):
- Myositis (HP:0100614): A general term for inflammation of the muscles without respect to the underlying cause. Evidence: TAS. (OMIM:160750)
- Proximal muscle weakness (HP:0003701): A lack of strength of the proximal muscles. Evidence: TAS. (OMIM:160750)
- Autosomal dominant inheritance (HP:0000006): A mode of inheritance that is observed for traits related to a gene encoded on one of the autosomes (i.e., the human chromosomes 1-22) in which a trait manifests in heterozygotes. In the context of medical genetics, an autosomal dominant disorder is caused when a single copy of the mutant allele is present. Males and females are affected equally, and can both transmit the disorder with a risk of 50% for each child of inheriting the mutant allele. Evidence: TAS. (OMIM:160750)